- Cirrhosis (HP:0001394): A chronic disorder of the liver in which liver tissue becomes scarred and is partially replaced by regenerative nodules and fibrotic tissue resulting in loss of liver function. Evidence: TAS. Frequency: Frequent (HP:0040282). (ORPHA:402823)
- Hepatitis (HP:0012115): Inflammation of the liver. Evidence: TAS. Frequency: Frequent (HP:0040282). (ORPHA:402823)
- Elevated circulating alanine aminotransferase concentration (HP:0031964): An abnormally high concentration in the circulation of alanine aminotransferase (ALT). Evidence: TAS. Frequency: Frequent (HP:0040282). (ORPHA:402823)
- Jaundice (HP:0000952): Yellow pigmentation of the skin due to bilirubin, which in turn is the result of increased bilirubin concentration in the bloodstream. Evidence: TAS. Frequency: Occasional (HP:0040283). (ORPHA:402823)
- Bruising susceptibility (HP:0000978): An ecchymosis (bruise) refers to the skin discoloration caused by the escape of blood into the tissues from ruptured blood vessels. This term refers to an abnormally increased susceptibility to bruising. The corresponding phenotypic abnormality is generally elicited on medical history as a report of frequent ecchymoses or bruising without adequate trauma. Evidence: TAS. Frequency: Occasional (HP:0040283). (ORPHA:402823)
- Confusion (HP:0001289): Lack of clarity and coherence of thought, perception, understanding, or action. Evidence: TAS. Frequency: Occasional (HP:0040283). (ORPHA:402823)
- Hepatic failure (HP:0001399). Evidence: TAS. Frequency: Occasional (HP:0040283). (ORPHA:402823)
- Abnormal bleeding (HP:0001892): An abnormal susceptibility to bleeding, often referred to as a bleeding diathesis. A bleeding diathesis may be related to vascular, platelet and coagulation defects. Evidence: TAS. Frequency: Occasional (HP:0040283). (ORPHA:402823)
- Fever (HP:0001945): Body temperature elevated above the normal range. Evidence: TAS. Frequency: Occasional (HP:0040283). (ORPHA:402823)
- Nausea and vomiting (HP:0002017): Nausea is a commonly encountered symptom that has been defined as an unpleasant painless subjective feeling that one will imminently vomit. Vomiting has been defined as the forceful expulsion of the contents of the stomach, duodenum, or jejunum through the oral cavity. While nausea and vomiting are often thought to exist on a temporal continuum, this is not always the case. There are situations when severe nausea may be present without emesis and less frequently, when emesis may be present without preceding nausea. Evidence: TAS. Frequency: Occasional (HP:0040283). (ORPHA:402823)
- Abdominal pain (HP:0002027): An unpleasant sensation characterized by physical discomfort (such as pricking, throbbing, or aching) and perceived to originate in the abdomen. Evidence: TAS. Frequency: Occasional (HP:0040283). (ORPHA:402823)
- Anorexia (HP:0002039): Lack of desire to eat (loss of appetite). Evidence: TAS. Frequency: Occasional (HP:0040283). (ORPHA:402823)
- Poor appetite (HP:0004396): A reduced desire to eat. Evidence: TAS. Frequency: Occasional (HP:0040283). (ORPHA:402823)
- Fulminant hepatitis (HP:0004787): Acute hepatitis complicated by acute liver failure with hepatic encephalopathy occurring less than 8 weeks after the onset of jaundice. Evidence: TAS. Frequency: Occasional (HP:0040283). (ORPHA:402823)
- Fatigue (HP:0012378): A subjective feeling of tiredness characterized by a lack of energy and motivation. Evidence: TAS. Frequency: Occasional (HP:0040283). (ORPHA:402823)
- Elevated circulating aspartate aminotransferase concentration (HP:0031956): The concentration of aspartate aminotransferase (AST) in the blood circulation is above the upper limit of normal. Evidence: TAS. Frequency: Occasional (HP:0040283). (ORPHA:402823)
- Malaise (HP:0033834): A feeling of general discomfort, weakness, or lack of health. Evidence: TAS. Frequency: Occasional (HP:0040283). (ORPHA:402823)
- Hepatocellular carcinoma (HP:0001402): A kind of neoplasm of the liver that originates in hepatocytes and presents macroscopically as a soft and hemorrhagic tan mass in the liver. Evidence: TAS. Frequency: Very rare (HP:0040284). (ORPHA:402823)
These phenotypes are associated with the disease Hepatitis delta (ORPHA:402823).